Phenotypes associated with the disease retinitis pigmentosa 29 (OMIM:612165):
- Blindness (HP:0000618): Blindness is the condition of lacking visual perception defined as a profound reduction in visual perception. On the 6m visual acuity scale, blindness is defined as less than 3/60. On the 20ft visual acuity scale, blindness is defined as less than 20/400. On the decimal visual acuity scale, blindness is defined as less than 0.05. Blindness is typically characterized by a visual field of no greater than 10 degrees in radius around central fixation. Evidence: IEA. (OMIM:612165)
- Autosomal recessive inheritance (HP:0000007): A mode of inheritance that is observed for traits related to a gene encoded on one of the autosomes (i.e., the human chromosomes 1-22) in which a trait manifests in individuals with two pathogenic alleles, either homozygotes (two copies of the same mutant allele) or compound heterozygotes (whereby each copy of a gene has a distinct mutant allele). Evidence: TAS. (OMIM:612165)
- Rod-cone dystrophy (HP:0000510): An inherited retinal disease subtype in which the rod photoreceptors appear to be more severely affected than the cone photoreceptors. Typical presentation is with nyctalopia (due to rod dysfunction) followed by loss of mid-peripheral field of vision, which gradually extends and leaves many patients with a small central island of vision due to the preservation of macular cones. Evidence: TAS. (OMIM:612165)
- Attenuation of retinal blood vessels (HP:0007843): Narrowing of the retinal blood vessels, both arterioles and venules. Evidence: TAS. (OMIM:612165)